- Abnormal foot morphology (HP:0001760): An abnormality of the skeleton of foot. Evidence: IEA. (OMIM:608323)
- Hand muscle weakness (HP:0030237): Reduced strength of the musculature of the hand. Evidence: PCS. Frequency: 1/1. (PMID:24354524)
- Decreased motor nerve conduction velocity (HP:0003431): A type of decreased nerve conduction velocity that affects the motor neuron. Evidence: PCS. Frequency: 1/1. (PMID:24354524)
- Gait disturbance (HP:0001288): The term gait disturbance can refer to any disruption of the ability to walk. Evidence: PCS. Frequency: 1/1. (PMID:24354524)
- Upper limb muscle weakness (HP:0003484): Weakness of the muscles of the arms. Evidence: IEA. (OMIM:608323)
- Distal amyotrophy (HP:0003693): Muscular atrophy affecting muscles in the distal portions of the extremities. Evidence: PCS. Frequency: 1/1. (PMID:24354524)
- Onion bulb formation (HP:0003383): Repeated episodes of segmental demyelination and remyelination lead to the accumulation of supernumerary Schwann cells around axons, which is referred to as onion bulb formation. This finding affects peripheral nerves. Evidence: PCS. Frequency: 0/1. (PMID:24354524)
- Distal muscle weakness (HP:0002460): Reduced strength of the musculature of the distal extremities. Evidence: PCS. Frequency: 1/1. (PMID:24354524)
- Axonal regeneration (HP:0003450): The presence of axonal regeneration following a previous axonal lesion. Evidence: IEA. (OMIM:608323)
- Areflexia (HP:0001284): Absence of neurologic reflexes such as the knee-jerk reaction. Evidence: PCS. Frequency: 1/1. (PMID:24354524)
- Intermediate young adult onset (HP:0025709): Onset of disease at an age of greater than or equal to 19 to under 25 years. Evidence: PCS. Frequency: 1/1. (PMID:24354524)
- Difficulty running (HP:0009046): Reduced ability to run. Evidence: PCS. Frequency: 1/1. (PMID:24354524)
- Distal sensory impairment (HP:0002936): An abnormal reduction in sensation in the distal portions of the extremities. Evidence: PCS. Frequency: 1/1. (PMID:24354524)
- Decreased sensory nerve conduction velocity (HP:0003448): Reduced speed of conduction of the action potential along a sensory nerve. Evidence: PCS. Frequency: 1/1. (PMID:24354524)
- Autosomal dominant inheritance (HP:0000006): A mode of inheritance that is observed for traits related to a gene encoded on one of the autosomes (i.e., the human chromosomes 1-22) in which a trait manifests in heterozygotes. In the context of medical genetics, an autosomal dominant disorder is caused when a single copy of the mutant allele is present. Males and females are affected equally, and can both transmit the disorder with a risk of 50% for each child of inheriting the mutant allele. Evidence: PCS. (PMID:16429158)
These phenotypes are associated with the disease Charcot-Marie-Tooth disease dominant intermediate C (OMIM:608323).